- Arthritis (HP:0001369): Inflammation of a joint. Evidence: TAS. Frequency: Very frequent (HP:0040281). (ORPHA:1416)
- Joint swelling (HP:0001386). Evidence: TAS. Frequency: Very frequent (HP:0040281). (ORPHA:1416)
- Arthralgia (HP:0002829): Joint pain. Evidence: TAS. Frequency: Very frequent (HP:0040281). (ORPHA:1416)
- Abnormal intervertebral disk morphology (HP:0005108): Any structural abnormality of the intervertebral disk. Evidence: TAS. Frequency: Very frequent (HP:0040281). (ORPHA:1416)
- Calcification of cartilage (HP:0100593): The presence of calcium deposition in cartilage. Evidence: TAS. Frequency: Very frequent (HP:0040281). (ORPHA:1416)
- Osteoarthritis (HP:0002758): Degeneration (wear and tear) of articular cartilage, i.e., of the joint surface. Joint degeneration may be accompanied by osteophytes (bone overgrowth), narrowing of the joint space, regions of sclerosis at the joint surface, or joint deformity. Evidence: TAS. Frequency: Frequent (HP:0040282). (ORPHA:1416)
- Chondrocalcinosis (HP:0000934): Radiographic evidence of articular calcification that represent calcium pyrophosphate depositions in soft tissue surrounding joints and at the insertions of tendons near joints (Entheses/Sharpey fibers) . Evidence: TAS. Frequency: Occasional (HP:0040283). (ORPHA:1416)
- Joint dislocation (HP:0001373): Displacement or malalignment of joints. Evidence: TAS. Frequency: Occasional (HP:0040283). (ORPHA:1416)
- Limitation of joint mobility (HP:0001376): A reduction in the freedom of movement of one or more joints. Evidence: TAS. Frequency: Occasional (HP:0040283). (ORPHA:1416)
- Joint stiffness (HP:0001387): Joint stiffness is a perceived sensation of tightness in a joint or joints when attempting to move them after a period of inactivity. Joint stiffness typically subsides over time. Evidence: TAS. Frequency: Occasional (HP:0040283). (ORPHA:1416)
- Fever (HP:0001945): Body temperature elevated above the normal range. Evidence: TAS. Frequency: Occasional (HP:0040283). (ORPHA:1416)
- Reduced bone mineral density (HP:0004349): A reduction of bone mineral density, that is, of the amount of matter per cubic centimeter of bones. Evidence: TAS. Frequency: Occasional (HP:0040283). (ORPHA:1416)
- Increased inflammatory response (HP:0012649): A abnormal increase in the inflammatory response to injury or infection. Evidence: TAS. Frequency: Occasional (HP:0040283). (ORPHA:1416)
- Ankylosis (HP:0031013): A reduction of joint mobility resulting from changes involving the articular surfaces. Evidence: TAS. Frequency: Occasional (HP:0040283). (ORPHA:1416)
- Decreased body mass index (HP:0045082): Abnormally decreased weight-to-height squared ratio, calculated by dividing the individual's weight in kilograms by the square of the individual's height in meters and used as an indicator of underweight compared to averages. Evidence: TAS. Frequency: Occasional (HP:0040283). (ORPHA:1416)
- Synovitis (HP:0100769). Evidence: TAS. Frequency: Occasional (HP:0040283). (ORPHA:1416)
- Seizure (HP:0001250): A seizure is an intermittent abnormality of nervous system physiology characterized by a transient occurrence of signs and/or symptoms due to abnormal excessive or synchronous neuronal activity in the brain. Evidence: TAS. Frequency: Very rare (HP:0040284). (ORPHA:1416)
These phenotypes are associated with the disease Familial calcium pyrophosphate deposition (ORPHA:1416).